Phenotypes associated with the disease Severe disseminated cytomegalovirus infection in immunocompetent patients (ORPHA:35062):
- Colitis (HP:0002583): Colitis refers to an inflammation of the colon and is often used to describe an inflammation of the large intestine (colon, cecum and rectum). Colitides may be acute and self-limited or chronic, and broadly fit into the category of digestive diseases. Evidence: TAS. Frequency: Very frequent (HP:0040281). (ORPHA:35062)
- Cytomegalovirus colitis (HP:0033431): Infection and inflammation of the colon caused by cytomegalovirus (CMV) infection that occurs in the context of unusual susceptibility to infection. Evidence: TAS. Frequency: Very frequent (HP:0040281). (ORPHA:35062)
- Uveitis (HP:0000554): Inflammation of one or all portions of the uveal tract. Evidence: TAS. Frequency: Frequent (HP:0040282). (ORPHA:35062)
- Meningitis (HP:0001287): Inflammation of the meninges. Evidence: TAS. Frequency: Frequent (HP:0040282). (ORPHA:35062)
- Weight loss (HP:0001824): Reduction of total body weight. Evidence: TAS. Frequency: Frequent (HP:0040282). (ORPHA:35062)
- Fever (HP:0001945): Body temperature elevated above the normal range. Evidence: TAS. Frequency: Frequent (HP:0040282). (ORPHA:35062)
- Nausea and vomiting (HP:0002017): Nausea is a commonly encountered symptom that has been defined as an unpleasant painless subjective feeling that one will imminently vomit. Vomiting has been defined as the forceful expulsion of the contents of the stomach, duodenum, or jejunum through the oral cavity. While nausea and vomiting are often thought to exist on a temporal continuum, this is not always the case. There are situations when severe nausea may be present without emesis and less frequently, when emesis may be present without preceding nausea. Evidence: TAS. Frequency: Frequent (HP:0040282). (ORPHA:35062)
- Abdominal pain (HP:0002027): An unpleasant sensation characterized by physical discomfort (such as pricking, throbbing, or aching) and perceived to originate in the abdomen. Evidence: TAS. Frequency: Frequent (HP:0040282). (ORPHA:35062)
- Anorexia (HP:0002039): Lack of desire to eat (loss of appetite). Evidence: TAS. Frequency: Frequent (HP:0040282). (ORPHA:35062)
- Pneumonia (HP:0002090): Inflammation of any part of the lung parenchyma. Evidence: TAS. Frequency: Frequent (HP:0040282). (ORPHA:35062)
- Interstitial pneumonitis (HP:0006515). Evidence: TAS. Frequency: Frequent (HP:0040282). (ORPHA:35062)
- Hepatitis (HP:0012115): Inflammation of the liver. Evidence: TAS. Frequency: Frequent (HP:0040282). (ORPHA:35062)
- Myelitis (HP:0012486): Inflammation of the spinal cord. Evidence: TAS. Frequency: Frequent (HP:0040282). (ORPHA:35062)
- Retinitis (HP:0032118): Inflammation of the retina of the eye. Evidence: TAS. Frequency: Frequent (HP:0040282). (ORPHA:35062)
- Viral encephalitis (HP:0033993): An inflammation of brain parenchyma due to infection with a virus. Viral encephalitis can occur as a rare complication of common infections (eg, herpes virus infections) or can occur as a characteristic presentation of rare viruses (eg, rabies virus infection). Encephalitis may be the only neurologic manifestation of infection, or may occur in association with meningitis, myelitis, radiculitis, or neuritis. Viral encephalitis is associated with neurological dysfunction. Evidence: TAS. Frequency: Frequent (HP:0040282). (ORPHA:35062)
- Anti-cytomegalovirus antibody positivity (HP:0430087): The presence of antibodies in the blood circulation that react against a component of cytomegalovirus (CMV). Evidence: TAS. Frequency: Frequent (HP:0040282). (ORPHA:35062)
- Visual loss (HP:0000572): Loss of visual acuity (implying that vision was better at a certain time point in life). Otherwise the term reduced visual acuity should be used (or a subclass of that). Evidence: TAS. Frequency: Occasional (HP:0040283). (ORPHA:35062)
- Purpura (HP:0000979): Purpura (from Latin: purpura, meaning purple) is the appearance of red or purple discolorations on the skin that do not blanch on applying pressure. They are caused by bleeding underneath the skin. This term refers to an abnormally increased susceptibility to developing purpura. Purpura are larger than petechiae. Evidence: TAS. Frequency: Occasional (HP:0040283). (ORPHA:35062)
- Skin rash (HP:0000988): A red eruption of the skin. Evidence: TAS. Frequency: Occasional (HP:0040283). (ORPHA:35062)
- Confusion (HP:0001289): Lack of clarity and coherence of thought, perception, understanding, or action. Evidence: TAS. Frequency: Occasional (HP:0040283). (ORPHA:35062)
- Pancreatitis (HP:0001733): The presence of inflammation in the pancreas. Evidence: TAS. Frequency: Occasional (HP:0040283). (ORPHA:35062)
- Thrombocytopenia (HP:0001873): A reduction in the number of circulating thrombocytes. Evidence: TAS. Frequency: Occasional (HP:0040283). (ORPHA:35062)
- Hemolytic anemia (HP:0001878): A type of anemia caused by premature destruction of red blood cells (hemolysis). Evidence: TAS. Frequency: Occasional (HP:0040283). (ORPHA:35062)
- Myalgia (HP:0003326): Pain in muscle. Evidence: TAS. Frequency: Occasional (HP:0040283). (ORPHA:35062)
- Venous thrombosis (HP:0004936): Formation of a blood clot (thrombus) inside a vein, causing the obstruction of blood flow. Evidence: TAS. Frequency: Occasional (HP:0040283). (ORPHA:35062)
- Splenic rupture (HP:0012223): A breach of the capsule of the spleen. Evidence: TAS. Frequency: Occasional (HP:0040283). (ORPHA:35062)
- Fatigue (HP:0012378): A subjective feeling of tiredness characterized by a lack of energy and motivation. Evidence: TAS. Frequency: Occasional (HP:0040283). (ORPHA:35062)
- Chills (HP:0025143): A sudden sensation of feeling cold. Evidence: TAS. Frequency: Occasional (HP:0040283). (ORPHA:35062)
- Duodenitis (HP:0033117): Inflammation of the lining of the upper small intestine (duodenum). Evidence: TAS. Frequency: Occasional (HP:0040283). (ORPHA:35062)